Phenotypes associated with the disease Early-onset parkinsonism-intellectual disability syndrome (ORPHA:2379):
- Macrocephaly (HP:0000256): Occipitofrontal (head) circumference greater than 97th centile compared to appropriate, age matched, sex-matched normal standards. Alternatively, a apparently increased size of the cranium. Evidence: TAS. Frequency: Very frequent (HP:0040281). (ORPHA:2379)
- Strabismus (HP:0000486): A misalignment of the eyes so that the visual axes deviate from bifoveal fixation. The classification of strabismus may be based on a number of features including the relative position of the eyes, whether the deviation is latent or manifest, intermittent or constant, concomitant or otherwise and according to the age of onset and the relevance of any associated refractive error. Evidence: TAS. Frequency: Frequent (HP:0040282). (ORPHA:2379)
- Intellectual disability (HP:0001249): The term intellectual disability or intellectual developmental disorder is used to describe significantly sub-average intellectual and adaptive functioning based on clinical assessment and as measured by individually administered, appropriately normed, standardized and validated tests of intellectual functioning and adaptive behavior, with onset during the developmental period from infancy through adolescence. Evidence: TAS. Frequency: Very frequent (HP:0040281). (ORPHA:2379)
- Seizure (HP:0001250): A seizure is an intermittent abnormality of nervous system physiology characterized by a transient occurrence of signs and/or symptoms due to abnormal excessive or synchronous neuronal activity in the brain. Evidence: TAS. Frequency: Frequent (HP:0040282). (ORPHA:2379)
- Frontal bossing (HP:0002007): Bilateral bulging of the lateral frontal bone prominences with relative sparing of the midline. Evidence: TAS. Frequency: Very frequent (HP:0040281). (ORPHA:2379)
- Rigidity (HP:0002063): Continuous involuntary sustained muscle contraction. When an affected muscle is passively stretched, the degree of resistance remains constant regardless of the rate at which the muscle is stretched. This feature helps to distinguish rigidity from muscle spasticity. Evidence: TAS. Frequency: Very frequent (HP:0040281). (ORPHA:2379)
- Abnormal speech pattern (HP:0002167): An abnormality in the sound (volume) or cadence (rate) of speech. Evidence: TAS. Frequency: Very frequent (HP:0040281). (ORPHA:2379)
- Cogwheel rigidity (HP:0002396): A type of rigidity in which a muscle responds with cogwheellike jerks to the use of constant force in bending the limb (i.e., it gives way in little, repeated jerks when the muscle is passively stretched). Evidence: TAS. Frequency: Very frequent (HP:0040281). (ORPHA:2379)
- Abnormality of movement (HP:0100022): An abnormality of movement with a neurological basis characterized by changes in coordination and speed of voluntary movements. Evidence: TAS. Frequency: Very frequent (HP:0040281). (ORPHA:2379)